Phenotypes associated with the disease diarrhea-vomiting due to trehalase deficiency (OMIM:612119):
- Diarrhea (HP:0002014): Abnormally increased frequency (usually defined as three or more) loose or watery bowel movements a day. Evidence: TAS. (OMIM:612119)
- Autosomal recessive inheritance (HP:0000007): A mode of inheritance that is observed for traits related to a gene encoded on one of the autosomes (i.e., the human chromosomes 1-22) in which a trait manifests in individuals with two pathogenic alleles, either homozygotes (two copies of the same mutant allele) or compound heterozygotes (whereby each copy of a gene has a distinct mutant allele). Evidence: TAS. (OMIM:612119)
- Abdominal pain (HP:0002027): An unpleasant sensation characterized by physical discomfort (such as pricking, throbbing, or aching) and perceived to originate in the abdomen. Evidence: IEA. (OMIM:612119)